Phenotypes associated with the disease Perry syndrome (ORPHA:178509):
- Depression (HP:0000716): Frequently experiencing feelings of being down, miserable, and/or hopeless; struggling to recover from these moods; having a pessimistic outlook on the future; feeling a pervasive sense of shame; having a low self-worth; experiencing thoughts of suicide and engaging in suicidal behavior. Evidence: TAS. Frequency: Very frequent (HP:0040281). (ORPHA:178509)
- Dementia (HP:0000726): A loss of global cognitive ability of sufficient amount to interfere with normal social or occupational function. Dementia represents a loss of previously present cognitive abilities, generally in adults, and can affect memory, thinking, language, judgment, and behavior. Evidence: TAS. Frequency: Occasional (HP:0040283). (ORPHA:178509)
- Apathy (HP:0000741): Apathy is a quantitative reduction of interest, motivation and the initiation and persistence of goal-directed behavior, where often the accompanying emotions, thoughts, and social interactions are also diminished. The individual is typically non-reactive to provocations, positive or negative, and appears to not care. Distinguished from lethargy which involves lack of physical or mental energy. Evidence: TAS. Frequency: Very frequent (HP:0040281). (ORPHA:178509)
- Personality changes (HP:0000751): An abnormal shift in patterns of thinking, acting, or feeling. Evidence: TAS. Frequency: Occasional (HP:0040283). (ORPHA:178509)
- Parkinsonism (HP:0001300): Characteristic neurologic anomaly resulting from degeneration of dopamine-generating cells in the substantia nigra, a region of the midbrain, characterized clinically by shaking, rigidity, slowness of movement and difficulty with walking and gait. Evidence: TAS. Frequency: Very frequent (HP:0040281). (ORPHA:178509)
- Tremor (HP:0001337): An unintentional, oscillating to-and-fro muscle movement about a joint axis. Evidence: TAS. Frequency: Very frequent (HP:0040281). (ORPHA:178509)
- Weight loss (HP:0001824): Reduction of total body weight. Evidence: TAS. Frequency: Very frequent (HP:0040281). (ORPHA:178509)
- Abnormality of extrapyramidal motor function (HP:0002071): A neurological condition related to lesions of the basal ganglia leading to typical abnormalities including akinesia (inability to initiate changes in activity and perform volitional movements rapidly and easily), muscular rigidity (continuous contraction of muscles with constant resistance to passive movement), chorea (widespread arrhythmic movements of a forcible, rapid, jerky, and restless nature), athetosis (inability to sustain the muscles of the fingers, toes, or other group of muscles in a fixed position), and akathisia (inability to remain motionless). Evidence: TAS. Frequency: Very frequent (HP:0040281). (ORPHA:178509)
- Sleep disturbance (HP:0002360): An abnormal pattern in the quality, quantity, or characteristics of sleep. Evidence: TAS. Frequency: Very frequent (HP:0040281). (ORPHA:178509)
- Hypotension (HP:0002615): Low Blood Pressure, vascular hypotension. Evidence: TAS. Frequency: Occasional (HP:0040283). (ORPHA:178509)
- Central hypoventilation (HP:0007110). Evidence: TAS. Frequency: Very frequent (HP:0040281). (ORPHA:178509)